Phenotypes associated with the disease essential hypertension, genetic (OMIM:145500):
- Elevated diastolic blood pressure (HP:0005117): Abnormal increase in diastolic blood pressure. Evidence: IEA. (OMIM:145500)
- Elevated mean arterial pressure (HP:0004972): An abnormal increase in the average blood pressure in an individual during a single cardiac cycle. Evidence: IEA. (OMIM:145500)
- Elevated systolic blood pressure (HP:0004421): Abnormal increase in systolic blood pressure. Evidence: IEA. (OMIM:145500)
- Non-Mendelian inheritance (HP:0001426): A mode of inheritance that depends on genetic determinants in more than one gene. Evidence: IEA. (OMIM:145500)